Phenotypes associated with the disease Paris-Trousseau thrombocytopenia (OMIM:188025):
- Abnormal bleeding (HP:0001892): An abnormal susceptibility to bleeding, often referred to as a bleeding diathesis. A bleeding diathesis may be related to vascular, platelet and coagulation defects. Evidence: IEA. (OMIM:188025)
- Trigonocephaly (HP:0000243): Wedge-shaped, or triangular head, with the apex of the triangle at the midline of the forehead and the base of the triangle at the occiput. Evidence: IEA. (OMIM:188025)
- Pyloric stenosis (HP:0002021): Pyloric stenosis, also known as infantile hypertrophic pyloric stenosis, is an uncommon condition in infants characterized by abnormal thickening of the pylorus muscles in the stomach leading to gastric outlet obstruction. Clinically infants are well at birth. Then, at 3 to 6 weeks of age, the infants present with projectile vomiting, potentially leading to dehydration and weight loss. Evidence: IEA. (OMIM:188025)
- Ptosis (HP:0000508): The upper eyelid margin is positioned 3 mm or more lower than usual and covers the superior portion of the iris (objective); or, the upper lid margin obscures at least part of the pupil (subjective). Evidence: IEA. (OMIM:188025)
- Prolonged bleeding time (HP:0003010): Prolongation of the time taken for a standardized skin cut of fixed depth and length to stop bleeding. Evidence: IEA. (OMIM:188025)
- Radial deviation of finger (HP:0009466): Bending or curvature of a finger toward the radial side (i.e., towards the thumb). The deviation is at the metacarpal-phalangeal joint, and this finding is distinct from clinodactyly. Evidence: IEA. (OMIM:188025)
- Clinodactyly (HP:0030084): An angulation of a digit at an interphalangeal joint in the plane of the palm (finger) or sole (toe). Evidence: TAS. (OMIM:188025)
- Sporadic (HP:0003745): Cases of the disease in question occur without a previous family history, i.e., as isolated cases without being transmitted from a parent and without other siblings being affected. Evidence: IEA. (OMIM:188025)
- Thrombocytopenia (HP:0001873): A reduction in the number of circulating thrombocytes. Evidence: IEA. (OMIM:188025)
- Micrognathia (HP:0000347): Developmental hypoplasia of the mandible. Evidence: TAS. (OMIM:188025)
- Intellectual disability (HP:0001249): The term intellectual disability or intellectual developmental disorder is used to describe significantly sub-average intellectual and adaptive functioning based on clinical assessment and as measured by individually administered, appropriately normed, standardized and validated tests of intellectual functioning and adaptive behavior, with onset during the developmental period from infancy through adolescence. Evidence: IEA. (OMIM:188025)